- Bilateral tonic-clonic seizure (HP:0002069): A bilateral tonic-clonic seizure is a seizure defined by a tonic (bilateral increased tone, lasting seconds to minutes) and then a clonic (bilateral sustained rhythmic jerking) phase. Evidence: PCS. Frequency: 1/1. (PMID:31678406)
- Axial hypotonia (HP:0008936): Muscular hypotonia (abnormally low muscle tone) affecting the musculature of the trunk. Evidence: PCS. Frequency: 1/1. (PMID:31678406)
- Hypsarrhythmia (HP:0002521): Hypsarrhythmia is abnormal interictal high amplitude waves and a background of irregular spikes. There is continuous (during wakefulness), high-amplitude (>200 Hz), generalized polymorphic slowing with no organized background and multifocal spikes demonstrated by electroencephalography (EEG). Evidence: PCS. Frequency: 1/1. (PMID:31678406)
- Absent speech (HP:0001344): Complete lack of development of speech and language abilities. Evidence: PCS. Frequency: 1/1. (PMID:31678406)
- Atonic seizure (HP:0010819): Atonic seizure is a type of motor seizure characterized by a sudden loss or diminution of muscle tone without apparent preceding myoclonic or tonic event lasting about 1 to 2 seconds, involving head, trunk, jaw, or limb musculature. Evidence: PCS. Frequency: 1/1. (PMID:31678406)
- Tonic seizure (HP:0032792): A tonic seizure is a type of motor seizure characterized by unilateral or bilateral limb stiffening or elevation, often with neck stiffening. Evidence: PCS. Frequency: 1/1. (PMID:31678406)
- Global developmental delay (HP:0001263): A delay in the achievement of motor or mental milestones in the domains of development of a child, including motor skills, speech and language, cognitive skills, and social and emotional skills. This term should only be used to describe children younger than five years of age. Evidence: PCS. Frequency: 1/1. (PMID:31678406)
- Infantile onset (HP:0003593): Onset of signs or symptoms of disease between 28 days to one year of life. Evidence: PCS. Frequency: 1/1. (PMID:31678406)
- Multifocal epileptiform discharges (HP:0010841): An abnormality in cerebral electrical activity recorded along the scalp by electroencephalography (EEG) and being identified at multiple locations (foci). Evidence: PCS. Frequency: 1/1. (PMID:31678406)
- Myoclonic seizure (HP:0032794): A myoclonic seizure is a type of motor seizure characterized by sudden, brief (<100 ms) involuntary single or multiple contraction of muscles or muscle groups of variable topography (axial, proximal limb, distal). Myoclonus is less regularly repetitive and less sustained than is clonus. Evidence: PCS. Frequency: 1/1. (PMID:31678406)
- Autosomal dominant inheritance (HP:0000006): A mode of inheritance that is observed for traits related to a gene encoded on one of the autosomes (i.e., the human chromosomes 1-22) in which a trait manifests in heterozygotes. In the context of medical genetics, an autosomal dominant disorder is caused when a single copy of the mutant allele is present. Males and females are affected equally, and can both transmit the disorder with a risk of 50% for each child of inheriting the mutant allele. Evidence: PCS. (PMID:31678406)
- Infantile spasms (HP:0012469): Infantile spasms represent a subset of "epileptic spasms". Infantile Spasms are epileptic spasms starting in the first year of life (infancy). Evidence: PCS. Frequency: 1/1. (PMID:31678406)
These phenotypes are associated with the disease developmental delay, impaired speech, and behavioral abnormalities, with or without seizures (OMIM:619964).